- Sensorineural hearing impairment (HP:0000407): A type of hearing impairment in one or both ears related to an abnormal functionality of the cochlear nerve. Evidence: TAS. Frequency: Very frequent (HP:0040281). (ORPHA:1490)
- Visual impairment (HP:0000505): Visual impairment (or vision impairment) is vision loss (of a person) to such a degree as to qualify as an additional support need through a significant limitation of visual capability resulting from either disease, trauma, or congenital or degenerative conditions that cannot be corrected by conventional means, such as refractive correction, medication, or surgery. Evidence: TAS. Frequency: Very frequent (HP:0040281). (ORPHA:1490)
- Nystagmus (HP:0000639): Rhythmic, involuntary oscillations of one or both eyes related to abnormality in fixation, conjugate gaze, or vestibular mechanisms. Evidence: TAS. Frequency: Frequent (HP:0040282). (ORPHA:1490)
- Corneal dystrophy (HP:0001131): The term corneal dystrophy embraces a heterogenous group of bilateral genetically determined non-inflammatory corneal diseases that are restricted to the cornea. Evidence: TAS. Frequency: Very frequent (HP:0040281). (ORPHA:1490)
- Corneal opacity (HP:0007957): A reduction of corneal clarity. Evidence: TAS. Frequency: Very frequent (HP:0040281). (ORPHA:1490)
These phenotypes are associated with the disease Corneal dystrophy-perceptive deafness syndrome (ORPHA:1490).